Phenotypes associated with the disease Hypodontia-dysplasia of nails syndrome (ORPHA:2228):
- Polycystic ovaries (HP:0000147). Evidence: TAS. Frequency: Occasional (HP:0040283). (ORPHA:2228)
- Abnormality of the dentition (HP:0000164): Any abnormality of the teeth. Evidence: TAS. Frequency: Very frequent (HP:0040281). (ORPHA:2228)
- Everted lower lip vermilion (HP:0000232): An abnormal configuration of the lower lip such that it is turned outward i.e., everted, with the Inner aspect of the lower lip vermilion (normally opposing the teeth) being visible in a frontal view. Evidence: TAS. Frequency: Frequent (HP:0040282). (ORPHA:2228)
- Hypodontia (HP:0000668): The absence of five or less teeth from the normal series by a failure to develop. Evidence: TAS. Frequency: Very frequent (HP:0040281). (ORPHA:2228)
- Delayed eruption of teeth (HP:0000684): Delayed tooth eruption, which can be defined as tooth eruption more than 2 SD beyond the mean eruption age. Evidence: TAS. Frequency: Very frequent (HP:0040281). (ORPHA:2228)
- Conical tooth (HP:0000698): An abnormal conical form of the teeth, that is, a tooth whose sides converge or taper together incisally. Evidence: TAS. Frequency: Very frequent (HP:0040281). (ORPHA:2228)
- Abnormal fingernail morphology (HP:0001231): An abnormality of the fingernails. Evidence: TAS. Frequency: Very frequent (HP:0040281). (ORPHA:2228)
- Abnormal nail morphology (HP:0001597): Abnormal structure or appearance of the nail. Evidence: TAS. Frequency: Very frequent (HP:0040281). (ORPHA:2228)
- Hypoplastic toenails (HP:0001800): Underdevelopment of the toenail. Evidence: TAS. Frequency: Very frequent (HP:0040281). (ORPHA:2228)
- Hypoplastic fingernail (HP:0001804): Underdevelopment of a fingernail. Evidence: TAS. Frequency: Very frequent (HP:0040281). (ORPHA:2228)
- Fragile nails (HP:0001808): Nails that easily break. Evidence: TAS. Frequency: Very frequent (HP:0040281). (ORPHA:2228)
- Fine hair (HP:0002213): Hair that is fine or thin to the touch. Evidence: TAS. Frequency: Frequent (HP:0040282). (ORPHA:2228)
- Agenesis of permanent teeth (HP:0006349): A congenital defect characterized by the absence of one or more permanent teeth, including oligodontia, hypodontia, and adontia of the of permanent teeth. Evidence: TAS. Frequency: Very frequent (HP:0040281). (ORPHA:2228)
- Abnormal dental morphology (HP:0006482): An abnormality of the morphology of the tooth. Evidence: TAS. Frequency: Very frequent (HP:0040281). (ORPHA:2228)
- Ridged fingernail (HP:0008402): Longitudinal, linear prominences in the fingernail plate. Evidence: TAS. Frequency: Very frequent (HP:0040281). (ORPHA:2228)
- Thin toenail (HP:0012746): Toenail that appears thin when viewed on end. Evidence: TAS. Frequency: Very frequent (HP:0040281). (ORPHA:2228)